- Microcephaly (HP:0000252): Head circumference below 2 standard deviations below the mean for age and gender. Evidence: TAS. Frequency: Occasional (HP:0040283). (ORPHA:293)
- Intrauterine growth retardation (HP:0001511): An abnormal restriction of fetal growth with fetal weight below the tenth percentile for gestational age. Evidence: TAS. Frequency: Frequent (HP:0040282). (ORPHA:293)
- Premature birth (HP:0001622): The birth of a baby of less than 37 weeks of gestational age. Evidence: TAS. Frequency: Frequent (HP:0040282). (ORPHA:293)
- Hydranencephaly (HP:0002324): A defect of development of the brain characterized by replacement of greater portions of the cerebral hemispheres and the corpus striatum by cerebrospinal fluid (CSF) and glial tissue. Evidence: TAS. Frequency: Occasional (HP:0040283). (ORPHA:293)
These phenotypes are associated with the disease Congenital herpes simplex virus infection (ORPHA:293).